Phenotypes associated with the disease mitochondrial complex I deficiency, nuclear type 9 (OMIM:618232):
- Encephalopathy (HP:0001298): Encephalopathy is a term that means brain disease, damage, or malfunction. In general, encephalopathy is manifested by an altered mental state. Evidence: IEA. (OMIM:618232)
- Lethargy (HP:0001254): A state of fatigue, either physical or mental slowness and sluggishness, with difficulties in initiating or performing simple tasks. Distinguished from apathy which implies indifference and a lack of desire or interest in the task. A person with lethargy may have the desire, but not the energy to engage in personal or socially relevant tasks. Evidence: IEA. (OMIM:618232)
- Feeding difficulties (HP:0011968): Impaired ability to eat related to problems gathering food and getting ready to suck, chew, or swallow it. Evidence: IEA. (OMIM:618232)
- Hypoventilation (HP:0002791): A reduction in the amount of air transported into the pulmonary alveoli by breathing, leading to hypercapnia (increase in the partial pressure of carbon dioxide). Evidence: IEA. (OMIM:618232)
- Seizure (HP:0001250): A seizure is an intermittent abnormality of nervous system physiology characterized by a transient occurrence of signs and/or symptoms due to abnormal excessive or synchronous neuronal activity in the brain. Evidence: IEA. Frequency: Very rare (HP:0040284). (OMIM:618232)
- Severe muscular hypotonia (HP:0006829): A severe degree of muscular hypotonia characterized by markedly reduced muscle tone. Evidence: IEA. (OMIM:618232)
- Decreased activity of mitochondrial complex I (HP:0011923): A reduction in the activity of the mitochondrial respiratory chain complex I, which is part of the electron transport chain in mitochondria. Evidence: PCS. Frequency: 1/1. (PMID:15372108)
- Nystagmus (HP:0000639): Rhythmic, involuntary oscillations of one or both eyes related to abnormality in fixation, conjugate gaze, or vestibular mechanisms. Evidence: IEA. (OMIM:618232)
- Autosomal recessive inheritance (HP:0000007): A mode of inheritance that is observed for traits related to a gene encoded on one of the autosomes (i.e., the human chromosomes 1-22) in which a trait manifests in individuals with two pathogenic alleles, either homozygotes (two copies of the same mutant allele) or compound heterozygotes (whereby each copy of a gene has a distinct mutant allele). Evidence: PCS. (PMID:15372108)
- Breathing dysregulation (HP:0005957). Evidence: IEA. (OMIM:618232)
- Neonatal death (HP:0003811): Death within the first 28 days of life. Evidence: PCS. Frequency: 2/2. (PMID:15372108)
- Lactic acidosis (HP:0003128): An abnormal buildup of lactic acid in the body, leading to acidification of the blood and other bodily fluids. Evidence: PCS. Frequency: 2/2. (PMID:15372108)
- Neonatal onset (HP:0003623): Onset of signs or symptoms of disease within the first 28 days of life. Evidence: PCS. Frequency: 2/2. (PMID:15372108)